- Diarrhea (HP:0002014): Abnormally increased frequency (usually defined as three or more) loose or watery bowel movements a day. Evidence: TAS. Frequency: Very frequent (HP:0040281). (ORPHA:35122)
- Abdominal pain (HP:0002027): An unpleasant sensation characterized by physical discomfort (such as pricking, throbbing, or aching) and perceived to originate in the abdomen. Evidence: TAS. Frequency: Very frequent (HP:0040281). (ORPHA:35122)
- Vomiting (HP:0002013): Forceful ejection of the contents of the stomach through the mouth by means of a series of involuntary spasmic contractions. Evidence: TAS. Frequency: Frequent (HP:0040282). (ORPHA:35122)
- Nausea (HP:0002018): A sensation of unease in the stomach together with an urge to vomit. Evidence: TAS. Frequency: Frequent (HP:0040282). (ORPHA:35122)
- Constipation (HP:0002019): Infrequent or difficult evacuation of feces. Evidence: TAS. Frequency: Frequent (HP:0040282). (ORPHA:35122)
- Gastroesophageal reflux (HP:0002020): A condition in which the stomach contents leak backwards from the stomach into the esophagus through the lower esophageal sphincter. Evidence: TAS. Frequency: Frequent (HP:0040282). (ORPHA:35122)
- Poor appetite (HP:0004396): A reduced desire to eat. Evidence: TAS. Frequency: Frequent (HP:0040282). (ORPHA:35122)
- Flatulence (HP:0033589): Passage of excessive amounts of gas and the feeling of abdominal fullness and bloating. Evidence: TAS. Frequency: Frequent (HP:0040282). (ORPHA:35122)
- Bowel incontinence (HP:0002607): Involuntary fecal soiling in adults and children who have usually already been toilet trained. Evidence: TAS. Frequency: Occasional (HP:0040283). (ORPHA:35122)
- Abdominal distention (HP:0003270): Distention of the abdomen. Evidence: TAS. Frequency: Occasional (HP:0040283). (ORPHA:35122)
- Abdominal colic (HP:0011848): A type of abdominal pain that comes and goes in waves, most often starting and ending suddenly and being of severe intensity. Evidence: TAS. Frequency: Occasional (HP:0040283). (ORPHA:35122)
- Fatigue (HP:0012378): A subjective feeling of tiredness characterized by a lack of energy and motivation. Evidence: TAS. Frequency: Occasional (HP:0040283). (ORPHA:35122)
- Bloody diarrhea (HP:0025085): Passage of many stools containing blood. Evidence: TAS. Frequency: Occasional (HP:0040283). (ORPHA:35122)
- Failure to thrive (HP:0001508): Failure to thrive (FTT) refers to a child whose physical growth is substantially below the norm. Evidence: TAS. Frequency: Very rare (HP:0040284). (ORPHA:35122)
These phenotypes are associated with the disease Congenital sucrase-isomaltase deficiency (ORPHA:35122).